- Abnormality of the dentition (HP:0000164): Any abnormality of the teeth. Evidence: IEA. (OMIM:187000)
- Autosomal dominant inheritance (HP:0000006): A mode of inheritance that is observed for traits related to a gene encoded on one of the autosomes (i.e., the human chromosomes 1-22) in which a trait manifests in heterozygotes. In the context of medical genetics, an autosomal dominant disorder is caused when a single copy of the mutant allele is present. Males and females are affected equally, and can both transmit the disorder with a risk of 50% for each child of inheriting the mutant allele. Evidence: IEA. (OMIM:187000)
These phenotypes are associated with the disease teeth, odd shapes of (OMIM:187000).